Phenotypes associated with the disease progressive myoclonic epilepsy type 7 (OMIM:616187, an entry in Online Mendelian Inheritance in Man):
- Bilateral tonic-clonic seizure (HP:0002069, a Human Phenotype Ontology term): A bilateral tonic-clonic seizure is a seizure defined by a tonic (bilateral increased tone, lasting seconds to minutes) and then a clonic (bilateral sustained rhythmic jerking) phase. Evidence: PCS. Frequency: 15/15. (PMID:25401298)
- Progressive (HP:0003676, a Human Phenotype Ontology term): Applies to a disease manifestation that increases in scope or severity over the course of time, i.e., that worsens with age. Evidence: PCS. (PMID:25401298)
- Juvenile onset (HP:0003621, a Human Phenotype Ontology term): Onset of signs or symptoms of disease between the age of 5 and 15 years. Evidence: PCS. Frequency: 14/15. (PMID:25401298)
- Cerebellar atrophy (HP:0001272, a Human Phenotype Ontology term): Cerebellar atrophy is defined as a cerebellum with initially normal structures, in a posterior fossa with normal size, which displays enlarged fissures (interfolial spaces) in comparison to the foliae secondary to loss of tissue. Cerebellar atrophy implies irreversible loss of tissue and result from an ongoing progressive disease until a final stage is reached or a single injury, e.g. an intoxication or infectious event. Evidence: PCS. Frequency: Occasional (HP:0040283, a Human Phenotype Ontology term). (PMID:25401298)
- Childhood onset (HP:0011463, a Human Phenotype Ontology term): Onset of disease at the age of between 1 and 5 years. Evidence: PCS. Frequency: 1/15. (PMID:25401298)
- EEG with generalized epileptiform discharges (HP:0011198, a Human Phenotype Ontology term): EEG discharges recorded on the entire scalp typically seen in persons with epilepsy. Evidence: PCS. Frequency: 16/16. (PMID:25401298)
- Ataxia (HP:0001251, a Human Phenotype Ontology term): Ataxia refers to impaired coordination of voluntary muscle movement. Cerebellar ataxia refers to ataxia due to dysfunction of the cerebellum. This causes a variety of elementary neurological deficits including asynergy (lack of coordination between muscles, limbs and joints), dysmetria (lack of ability to judge distances that can lead to under- or overshoot in grasping movements), and dysdiadochokinesia (inability to perform rapid movements requiring antagonizing muscle groups to be switched on and off repeatedly). Evidence: PCS. Frequency: 1/16. (PMID:25401298)
- Myoclonic seizure (HP:0032794, a Human Phenotype Ontology term): A myoclonic seizure is a type of motor seizure characterized by sudden, brief (<100 ms) involuntary single or multiple contraction of muscles or muscle groups of variable topography (axial, proximal limb, distal). Myoclonus is less regularly repetitive and less sustained than is clonus. Evidence: PCS. Frequency: 14/15. (PMID:25401298)
- Mental deterioration (HP:0001268, a Human Phenotype Ontology term): Loss of previously present mental abilities, generally in adults. Evidence: PCS. Frequency: 9/15. (PMID:25401298)
- Tremor (HP:0001337, a Human Phenotype Ontology term): An unintentional, oscillating to-and-fro muscle movement about a joint axis. Evidence: PCS. (PMID:25401298)
- Autosomal dominant inheritance (HP:0000006, a Human Phenotype Ontology term): A mode of inheritance that is observed for traits related to a gene encoded on one of the autosomes (i.e., the human chromosomes 1-22) in which a trait manifests in heterozygotes. In the context of medical genetics, an autosomal dominant disorder is caused when a single copy of the mutant allele is present. Males and females are affected equally, and can both transmit the disorder with a risk of 50% for each child of inheriting the mutant allele. Evidence: PCS. (PMID:25401298)
- Myoclonus (HP:0001336, a Human Phenotype Ontology term): Very brief, involuntary random muscular contractions occurring at rest, in response to sensory stimuli, or accompanying voluntary movements. Evidence: PCS. Frequency: 16/16. (PMID:25401298)